- Sex reversal (HP:0012245): Development of the reproductive system is inconsistent with the chromosomal sex. Evidence: TAS. (OMIM:300018)
- X-linked inheritance (HP:0001417): A mode of inheritance that is observed for traits related to a gene encoded on the X chromosome. Evidence: TAS. (OMIM:300018)
These phenotypes are associated with the disease 46,XY sex reversal 2 (OMIM:300018).